Phenotypes associated with the disease spinocerebellar ataxia, autosomal recessive 24 (OMIM:617133):
- Progressive (HP:0003676): Applies to a disease manifestation that increases in scope or severity over the course of time, i.e., that worsens with age. Evidence: PCS. (PMID:26872069)
- Juvenile onset (HP:0003621): Onset of signs or symptoms of disease between the age of 5 and 15 years. Evidence: PCS. Frequency: 1/2. (PMID:26872069)
- Cataract (HP:0000518): A cataract is an opacity or clouding that develops in the crystalline lens of the eye or in its capsule. Evidence: PCS. Frequency: 2/2. (PMID:26872069)
- Cerebellar atrophy (HP:0001272): Cerebellar atrophy is defined as a cerebellum with initially normal structures, in a posterior fossa with normal size, which displays enlarged fissures (interfolial spaces) in comparison to the foliae secondary to loss of tissue. Cerebellar atrophy implies irreversible loss of tissue and result from an ongoing progressive disease until a final stage is reached or a single injury, e.g. an intoxication or infectious event. Evidence: PCS. Frequency: 2/2. (PMID:26872069)
- Dysarthria (HP:0001260): Dysarthric speech is a general description referring to a neurological speech disorder characterized by poor articulation. Depending on the involved neurological structures, dysarthria may be further classified as spastic, flaccid, ataxic, hyperkinetic and hypokinetic, or mixed. Evidence: PCS. Frequency: 2/2. (PMID:26872069)
- Gait ataxia (HP:0002066): A type of ataxia characterized by the impairment of the ability to coordinate the movements required for normal walking. Gait ataxia is characteirzed by a wide-based staggering gait with a tendency to fall. Evidence: PCS. Frequency: 2/2. (PMID:26872069)
- Childhood onset (HP:0011463): Onset of disease at the age of between 1 and 5 years. Evidence: PCS. Frequency: 1/2. (PMID:26872069)
- Spastic gait (HP:0002064): Spasticity is manifested by increased stretch reflex which is intensified with movement velocity. This results in excessive and inappropriate muscle activation which can contribute to muscle hypertonia. Spastic gait is characterized by manifestations such as muscle hypertonia, stiff knee, and circumduction of the leg. Evidence: PCS. Frequency: 1/2. (PMID:26872069)
- Autosomal recessive inheritance (HP:0000007): A mode of inheritance that is observed for traits related to a gene encoded on one of the autosomes (i.e., the human chromosomes 1-22) in which a trait manifests in individuals with two pathogenic alleles, either homozygotes (two copies of the same mutant allele) or compound heterozygotes (whereby each copy of a gene has a distinct mutant allele). Evidence: PCS. (PMID:26872069)
- Limb ataxia (HP:0002070): A kind of ataxia that affects movements of the extremities. Evidence: PCS. Frequency: 2/2. (PMID:26872069)
- Horizontal nystagmus (HP:0000666): Nystagmus consisting of horizontal to-and-fro eye movements. Evidence: PCS. Frequency: 2/2. (PMID:26872069)